- Cerebral visual impairment (HP:0100704): A form of loss of vision caused by damage to the visual cortex rather than a defect in the eye. Evidence: TAS. (OMIM:272100)
- Diffuse cerebral sclerosis (HP:0006918). Evidence: TAS. (OMIM:272100)
- Autosomal recessive inheritance (HP:0000007): A mode of inheritance that is observed for traits related to a gene encoded on one of the autosomes (i.e., the human chromosomes 1-22) in which a trait manifests in individuals with two pathogenic alleles, either homozygotes (two copies of the same mutant allele) or compound heterozygotes (whereby each copy of a gene has a distinct mutant allele). Evidence: TAS. (OMIM:272100)
These phenotypes are associated with the disease Schilder disease (OMIM:272100).